- Hearing impairment (HP:0000365): A decreased magnitude of the sensory perception of sound. Evidence: PCS. (PMID:36048850)
- Young adult onset (HP:0011462): Onset of disease at the age of between 16 and 40 years. Evidence: PCS. (PMID:36048850)
- Autosomal dominant inheritance (HP:0000006): A mode of inheritance that is observed for traits related to a gene encoded on one of the autosomes (i.e., the human chromosomes 1-22) in which a trait manifests in heterozygotes. In the context of medical genetics, an autosomal dominant disorder is caused when a single copy of the mutant allele is present. Males and females are affected equally, and can both transmit the disorder with a risk of 50% for each child of inheriting the mutant allele. Evidence: PCS. (PMID:36048850)
These phenotypes are associated with the disease hearing loss, autosomal dominant 88 (OMIM:620283).